- Postaxial hand polydactyly (HP:0001162): Supernumerary digits located at the ulnar side of the hand (that is, on the side with the fifth finger). Evidence: PCS. Frequency: 3/3. (PMID:30395363)
- Autosomal recessive inheritance (HP:0000007): A mode of inheritance that is observed for traits related to a gene encoded on one of the autosomes (i.e., the human chromosomes 1-22) in which a trait manifests in individuals with two pathogenic alleles, either homozygotes (two copies of the same mutant allele) or compound heterozygotes (whereby each copy of a gene has a distinct mutant allele). Evidence: PCS. (PMID:30395363)
- Postaxial foot polydactyly (HP:0001830): Polydactyly of the foot most commonly refers to the presence of six toes on one foot. Postaxial polydactyly affects the lateral ray and the duplication may range from a well-formed articulated digit to a rudimentary digit. Evidence: PCS. Frequency: 1/3. (PMID:30395363)
These phenotypes are associated with the disease polydactyly, postaxial, type A9 (OMIM:618219).